- Bilateral tonic-clonic seizure (HP:0002069): A bilateral tonic-clonic seizure is a seizure defined by a tonic (bilateral increased tone, lasting seconds to minutes) and then a clonic (bilateral sustained rhythmic jerking) phase. Evidence: IEA. (OMIM:604352)
- Febrile seizure (within the age range of 3 months to 6 years) (HP:0002373): A febrile seizure is any type of seizure (most often a generalized tonic-clonic seizure) occurring with fever (at least 38 degrees Celsius) but in the absence of central nervous system infection, severe metabolic disturbance or other alternative precipitant in children between the ages of 3 months and 6 years. Evidence: TAS. (OMIM:604352)
- Atonic seizure (HP:0010819): Atonic seizure is a type of motor seizure characterized by a sudden loss or diminution of muscle tone without apparent preceding myoclonic or tonic event lasting about 1 to 2 seconds, involving head, trunk, jaw, or limb musculature. Evidence: IEA. (OMIM:604352)
- Childhood onset (HP:0011463): Onset of disease at the age of between 1 and 5 years. Evidence: TAS. (OMIM:604352)
- Generalized tonic seizure (HP:0010818): A generalized tonic seizure is a type of generalized motor seizure characterized by bilateral limb stiffening or elevation, often with neck stiffening without a subsequent clonic phase. The tonic activity can be a sustained abnormal posture, either in extension or flexion, sometimes accompanied by tremor of the extremities. Evidence: IEA. (OMIM:604352)
- Infantile onset (HP:0003593): Onset of signs or symptoms of disease between 28 days to one year of life. Evidence: TAS. (OMIM:604352)
- Autosomal dominant inheritance (HP:0000006): A mode of inheritance that is observed for traits related to a gene encoded on one of the autosomes (i.e., the human chromosomes 1-22) in which a trait manifests in heterozygotes. In the context of medical genetics, an autosomal dominant disorder is caused when a single copy of the mutant allele is present. Males and females are affected equally, and can both transmit the disorder with a risk of 50% for each child of inheriting the mutant allele. Evidence: IEA. (OMIM:604352)
These phenotypes are associated with the disease febrile seizures, familial, 4 (OMIM:604352).